Phenotypes associated with the disease Neuroendocrine tumor of stomach (ORPHA:100075):
- Bronchoconstriction (HP:4000007): Tightening of smooth muscle surrounding the bronchi and bronchioles with consequent wheezing and shortness of breath. Evidence: TAS. Frequency: Very rare (HP:0040284). (ORPHA:100075)
- Carcinoid tumor (HP:0100570): A tumor formed from the endocrine (argentaffin) cells of the mucosal lining of a variety of organs including the stomach and intestine. These cells are from neuroectodermal origin. Evidence: TAS. Frequency: Obligate (HP:0040280). (ORPHA:100075)
- Weight loss (HP:0001824): Reduction of total body weight. Evidence: TAS. Frequency: Frequent (HP:0040282). (ORPHA:100075)
- Iron deficiency anemia (HP:0001891). Evidence: TAS. Frequency: Frequent (HP:0040282). (ORPHA:100075)
- Nausea and vomiting (HP:0002017): Nausea is a commonly encountered symptom that has been defined as an unpleasant painless subjective feeling that one will imminently vomit. Vomiting has been defined as the forceful expulsion of the contents of the stomach, duodenum, or jejunum through the oral cavity. While nausea and vomiting are often thought to exist on a temporal continuum, this is not always the case. There are situations when severe nausea may be present without emesis and less frequently, when emesis may be present without preceding nausea. Evidence: TAS. Frequency: Frequent (HP:0040282). (ORPHA:100075)
- Anorexia (HP:0002039): Lack of desire to eat (loss of appetite). Evidence: TAS. Frequency: Frequent (HP:0040282). (ORPHA:100075)
- Intermittent diarrhea (HP:0002254): Repeated episodes of diarrhea separated by periods without diarrhea. Evidence: TAS. Frequency: Frequent (HP:0040282). (ORPHA:100075)
- Episodic abdominal pain (HP:0002574): An intermittent form of abdominal pain. Evidence: TAS. Frequency: Frequent (HP:0040282). (ORPHA:100075)
- Poor appetite (HP:0004396): A reduced desire to eat. Evidence: TAS. Frequency: Frequent (HP:0040282). (ORPHA:100075)
- Dermatological manifestations of systemic disorders (HP:0001005). Evidence: TAS. Frequency: Occasional (HP:0040283). (ORPHA:100075)
- Zollinger-Ellison syndrome (HP:0002044): A condition in which there is increased production of gastrin by a gastrin-secreting tumor (usually located in the pancreas, duodenum, or abdominal lymph nodes) that stimulates the gastric mucosa to maximal activity, with consequent gastrointestinal mucosal ulceration. Evidence: TAS. Frequency: Occasional (HP:0040283). (ORPHA:100075)
- Hepatomegaly (HP:0002240): Abnormally increased size of the liver. Evidence: TAS. Frequency: Occasional (HP:0040283). (ORPHA:100075)
- Hematemesis (HP:0002248): The vomiting of blood. Evidence: TAS. Frequency: Occasional (HP:0040283). (ORPHA:100075)
- Melena (HP:0002249): The passage of blackish, tarry feces associated with gastrointestinal hemorrhage. Melena occurs if the blood remains in the colon long enough for it to be broken down by colonic bacteria. One degradation product, hematin, imbues the stool with a blackish color. Thus, melena generally occurs with bleeding from the upper gastrointestinal tract (e.g., stomach ulcers or duodenal ulcers), since the blood usually remains in the gut for a longer period of time than with lower gastrointestinal bleeding. Evidence: TAS. Frequency: Occasional (HP:0040283). (ORPHA:100075)
- Chronic noninfectious lymphadenopathy (HP:0002730): A chronic form of lymphadenopathy that is not related to infection. Evidence: TAS. Frequency: Occasional (HP:0040283). (ORPHA:100075)
- Elevated circulating hepatic transaminase concentration (HP:0002910): Elevations of the levels of SGOT and SGPT in the serum. SGOT (serum glutamic oxaloacetic transaminase) and SGPT (serum glutamic pyruvic transaminase) are transaminases primarily found in the liver and heart and are released into the bloodstream as the result of liver or heart damage. SGOT and SGPT are used clinically mainly as markers of liver damage. Evidence: TAS. Frequency: Occasional (HP:0040283). (ORPHA:100075)
- Bloody diarrhea (HP:0025085): Passage of many stools containing blood. Evidence: TAS. Frequency: Occasional (HP:0040283). (ORPHA:100075)
- Lack of bowel sounds (HP:0030145): Complete lack of abdominal sounds as assayed by examination of the abdomen with a stethoscope. Evidence: TAS. Frequency: Occasional (HP:0040283). (ORPHA:100075)
- Atypical pulmonary carcinoid tumor (HP:0030446). Evidence: TAS. Frequency: Occasional (HP:0040283). (ORPHA:100075)
- Hepatic failure (HP:0001399). Evidence: TAS. Frequency: Very rare (HP:0040284). (ORPHA:100075)
- Right ventricular failure (HP:0001708): Reduced ability of the right ventricle to perform its function (to receive blood from the right atrium and to eject blood into the pulmonary artery), often leading to pitting peripheral edema, ascites, and hepatomegaly. Evidence: TAS. Frequency: Very rare (HP:0040284). (ORPHA:100075)
- Palpitations (HP:0001962): A sensation that the heart is pounding or racing, which is a non-specific sign but may be a manifestation of arrhythmia. Evidence: TAS. Frequency: Very rare (HP:0040284). (ORPHA:100075)
- Hypotension (HP:0002615): Low Blood Pressure, vascular hypotension. Evidence: TAS. Frequency: Very rare (HP:0040284). (ORPHA:100075)
- Paraganglioma (HP:0002668): A carotid body tumor (also called paraganglionoma or chemodectoma) is a tumor found in the upper neck at the branching of the carotid artery. They arise from the chemoreceptor organ (paraganglion) located in the adventitia of the carotid artery bifurcation. Evidence: TAS. Frequency: Very rare (HP:0040284). (ORPHA:100075)
- Increased serum serotonin (HP:0003144): A increased concentration of serotonin in the blood. Evidence: TAS. Frequency: Very rare (HP:0040284). (ORPHA:100075)
- Increased circulating ACTH level (HP:0003154): An abnormal increased in the concentration of corticotropin, also known as adrenocorticotropic hormone (ACTH), in the blood. Evidence: TAS. Frequency: Very rare (HP:0040284). (ORPHA:100075)
- Protracted diarrhea (HP:0004385). Evidence: TAS. Frequency: Very rare (HP:0040284). (ORPHA:100075)
- Tricuspid regurgitation (HP:0005180): Failure of the tricuspid valve to close sufficiently upon contraction of the right ventricle, causing blood to regurgitate (flow backward) into the right atrium. Evidence: TAS. Frequency: Very rare (HP:0040284). (ORPHA:100075)
- Facial telangiectasia (HP:0007380): Telangiectases (small dilated blood vessels) located near the surface of the skin of the face. Evidence: TAS. Frequency: Very rare (HP:0040284). (ORPHA:100075)
- Bowel urgency (HP:0012701): A sudden, irresistible need to have a bowel movement. Evidence: TAS. Frequency: Very rare (HP:0040284). (ORPHA:100075)
- Cardiogenic shock (HP:0030149): Severely decreased cardiac output with evidence of inadequate end-organ perfusion (i.e., tissue hypoxia) in the presence of adequate intravascular volume. Evidence: TAS. Frequency: Very rare (HP:0040284). (ORPHA:100075)
- Abnormal pulmonary valve cusp morphology (HP:0031566): Any structural anomaly of the pulmonary valve leaflets. Evidence: TAS. Frequency: Very rare (HP:0040284). (ORPHA:100075)